- Alopecia universalis (HP:0002289): Loss of all hair on the entire body. Evidence: PCS. (PMID:17236136)
- Alopecia totalis (HP:0007418): Loss of all scalp hair. Evidence: PCS. (PMID:17236136)
- Patchy alopecia (HP:0002232): Transient, non-scarring hair loss and preservation of the hair follicle located in in well-defined patches. Evidence: PCS. (PMID:17236136)
- Typified by incomplete penetrance (HP:0003829): Description of conditions in which not all individuals with a given genotype exhibit the disease. Penetrance is the proportion that develop disease given a lifespan of 80 years. Evidence: PCS. (PMID:17236136)
- Non-Mendelian inheritance (HP:0001426): A mode of inheritance that depends on genetic determinants in more than one gene. Evidence: PCS. (PMID:17236136)
- Alopecia of scalp (HP:0002293). Evidence: PCS. (PMID:17236136)
- Autosomal recessive inheritance (HP:0000007): A mode of inheritance that is observed for traits related to a gene encoded on one of the autosomes (i.e., the human chromosomes 1-22) in which a trait manifests in individuals with two pathogenic alleles, either homozygotes (two copies of the same mutant allele) or compound heterozygotes (whereby each copy of a gene has a distinct mutant allele). Evidence: IEA. (OMIM:610753)
- Autosomal dominant inheritance (HP:0000006): A mode of inheritance that is observed for traits related to a gene encoded on one of the autosomes (i.e., the human chromosomes 1-22) in which a trait manifests in heterozygotes. In the context of medical genetics, an autosomal dominant disorder is caused when a single copy of the mutant allele is present. Males and females are affected equally, and can both transmit the disorder with a risk of 50% for each child of inheriting the mutant allele. Evidence: IEA. (OMIM:610753)
These phenotypes are associated with the disease alopecia areata 2 (OMIM:610753).